Phenotypes associated with the disease type 1 diabetes mellitus (OMIM:222100):
- Diabetes mellitus (HP:0000819): A group of abnormalities characterized by hyperglycemia and glucose intolerance. Evidence: IEA. (OMIM:222100)
- Autoimmunity (HP:0002960): The occurrence of an immune reaction against the organism's own cells or tissues. Evidence: TAS. (OMIM:222100)
- Ketoacidosis (HP:0001993): Acidosis resulting from accumulation of ketone bodies. Evidence: IEA. (OMIM:222100)
- Polydipsia (HP:0001959): Excessive thirst manifested by excessive fluid intake. Evidence: IEA. (OMIM:222100)
- Polyphagia (HP:0002591): A neurological anomaly with gross overeating associated with an abnormally strong desire or need to eat. Evidence: IEA. (OMIM:222100)
- Hyperglycemia (HP:0003074): An increased concentration of glucose in the blood. Evidence: IEA. (OMIM:222100)
- Decreased circulating 1,5 anhydroglucitol concentration (HP:0410050): Concetration of 1,5 anhydroglucitol in the blood circulation is below the lower limit of normal. Evidence: PCS. Frequency: 30/30. (PMID:9357814;PMID:17659063;PMID:16731998)
- Polyuria (HP:0000103): An increased rate of urine production. Evidence: IEA. (OMIM:222100)